Phenotypes associated with the disease chromosome 1q21.1 duplication syndrome (DECIPHER:67):
- Autism (HP:0000717): Autism is a neurodevelopmental disorder characterized by impaired social interaction and communication, and by restricted and repetitive behavior. Autism begins in childhood. It is marked by the presence of markedly abnormal or impaired development in social interaction and communication and a markedly restricted repertoire of activity and interest. Manifestations of the disorder vary greatly depending on the developmental level and chronological age of the individual (DSM-IV). Evidence: IEA. (DECIPHER:67)
- Intellectual disability (HP:0001249): The term intellectual disability or intellectual developmental disorder is used to describe significantly sub-average intellectual and adaptive functioning based on clinical assessment and as measured by individually administered, appropriately normed, standardized and validated tests of intellectual functioning and adaptive behavior, with onset during the developmental period from infancy through adolescence. Evidence: IEA. (DECIPHER:67)